- Hydronephrosis (HP:0000126): Severe distention of the kidney with dilation of the renal pelvis and calices. Evidence: TAS. Frequency: Occasional (HP:0040283). (ORPHA:1727)
- Cleft palate (HP:0000175): Cleft palate is a developmental defect of the palate resulting from a failure of fusion of the palatine processes and manifesting as a separation of the roof of the mouth (soft and hard palate). Evidence: TAS. Frequency: Frequent (HP:0040282). (ORPHA:1727)
- Microcephaly (HP:0000252): Head circumference below 2 standard deviations below the mean for age and gender. Evidence: TAS. Frequency: Occasional (HP:0040283). (ORPHA:1727)
- Narrow face (HP:0000275): Bizygomatic (upper face) and bigonial (lower face) width are both more than 2 standard deviations below the mean (objective); or, an apparent reduction in the width of the upper and lower face (subjective). Evidence: TAS. Frequency: Frequent (HP:0040282). (ORPHA:1727)
- Epicanthus (HP:0000286): A fold of skin starting above the medial aspect of the upper eyelid and arching downward to cover, pass in front of and lateral to the medial canthus. Evidence: TAS. Frequency: Frequent (HP:0040282). (ORPHA:1727)
- Hypertelorism (HP:0000316): Interpupillary distance more than 2 SD above the mean (alternatively, the appearance of an increased interpupillary distance or widely spaced eyes). Evidence: TAS. Frequency: Frequent (HP:0040282). (ORPHA:1727)
- Smooth philtrum (HP:0000319): Flat skin surface, with no ridge formation in the central region of the upper lip between the nasal base and upper vermilion border. Evidence: TAS. Frequency: Occasional (HP:0040283). (ORPHA:1727)
- Micrognathia (HP:0000347): Developmental hypoplasia of the mandible. Evidence: TAS. Frequency: Occasional (HP:0040283). (ORPHA:1727)
- High forehead (HP:0000348): An abnormally increased height of the forehead. Evidence: TAS. Frequency: Frequent (HP:0040282). (ORPHA:1727)
- Hearing impairment (HP:0000365): A decreased magnitude of the sensory perception of sound. Evidence: TAS. Frequency: Occasional (HP:0040283). (ORPHA:1727)
- Wide nose (HP:0000445): Interalar distance more than two standard deviations above the mean for age, i.e., an apparently increased width of the nasal base and alae. Evidence: TAS. Frequency: Occasional (HP:0040283). (ORPHA:1727)
- Depressed nasal ridge (HP:0000457): Lack of prominence of the nose resulting from a posteriorly-placed nasal ridge. Evidence: TAS. Frequency: Frequent (HP:0040282). (ORPHA:1727)
- Downslanted palpebral fissures (HP:0000494): The palpebral fissure inclination is more than two standard deviations below the mean. Evidence: TAS. Frequency: Frequent (HP:0040282). (ORPHA:1727)
- Ptosis (HP:0000508): The upper eyelid margin is positioned 3 mm or more lower than usual and covers the superior portion of the iris (objective); or, the upper lid margin obscures at least part of the pupil (subjective). Evidence: TAS. Frequency: Occasional (HP:0040283). (ORPHA:1727)
- Abnormality of the pharynx (HP:0000600): An anomaly of the pharynx, i.e., of the tubular structure extending from the base of the skull superiorly to the esophageal inlet inferiorly. Evidence: TAS. Frequency: Frequent (HP:0040282). (ORPHA:1727)
- Autism (HP:0000717): Autism is a neurodevelopmental disorder characterized by impaired social interaction and communication, and by restricted and repetitive behavior. Autism begins in childhood. It is marked by the presence of markedly abnormal or impaired development in social interaction and communication and a markedly restricted repertoire of activity and interest. Manifestations of the disorder vary greatly depending on the developmental level and chronological age of the individual (DSM-IV). Evidence: TAS. Frequency: Occasional (HP:0040283). (ORPHA:1727)
- Compulsive behaviors (HP:0000722): Behavior that consists of repetitive acts, characterized by the feeling that one "has to" perform them, while being aware that these acts are not in line with one's overall goal. Evidence: TAS. Frequency: Occasional (HP:0040283). (ORPHA:1727)
- Motor stereotypy (HP:0000733): Use of the same abnormal action in response to certain triggers or at random. They may be used as a way to regulate one's internal state but must otherwise have no apparent functional purpose. Evidence: TAS. Frequency: Occasional (HP:0040283). (ORPHA:1727)
- Anxiety (HP:0000739): Intense feelings of nervousness, tension, or panic often arise in response to interpersonal stresses. There is worry about the negative effects of past unpleasant experiences and future negative possibilities. Individuals may feel fearful, apprehensive, or threatened by uncertainty, and they may also have fears of falling apart or losing control. Evidence: TAS. Frequency: Occasional (HP:0040283). (ORPHA:1727)
- Delayed speech and language development (HP:0000750): A degree of language development that is significantly below the norm for a child of a specified age. Evidence: TAS. Frequency: Frequent (HP:0040282). (ORPHA:1727)
- Intellectual disability (HP:0001249): The term intellectual disability or intellectual developmental disorder is used to describe significantly sub-average intellectual and adaptive functioning based on clinical assessment and as measured by individually administered, appropriately normed, standardized and validated tests of intellectual functioning and adaptive behavior, with onset during the developmental period from infancy through adolescence. Evidence: TAS. Frequency: Frequent (HP:0040282). (ORPHA:1727)
- Seizure (HP:0001250): A seizure is an intermittent abnormality of nervous system physiology characterized by a transient occurrence of signs and/or symptoms due to abnormal excessive or synchronous neuronal activity in the brain. Evidence: TAS. Frequency: Occasional (HP:0040283). (ORPHA:1727)
- Hypotonia (HP:0001252): Hypotonia is an abnormally low muscle tone (the amount of tension or resistance to movement in a muscle). Even when relaxed, muscles have a continuous and passive partial contraction which provides some resistance to passive stretching. Hypotonia thus manifests as diminished resistance to passive stretching. Hypotonia is not the same as muscle weakness, although the two conditions can co-exist. Evidence: TAS. Frequency: Frequent (HP:0040282). (ORPHA:1727)
- Global developmental delay (HP:0001263): A delay in the achievement of motor or mental milestones in the domains of development of a child, including motor skills, speech and language, cognitive skills, and social and emotional skills. This term should only be used to describe children younger than five years of age. Evidence: TAS. Frequency: Frequent (HP:0040282). (ORPHA:1727)
- Growth delay (HP:0001510): A deficiency or slowing down of growth pre- and postnatally. Evidence: TAS. Frequency: Occasional (HP:0040283). (ORPHA:1727)
- Hypernasal speech (HP:0001611): A type of speech characterized by the presence of an abnormally increased nasal airflow during speech associated with structural abnormality of the nasal passages. Evidence: TAS. Frequency: Frequent (HP:0040282). (ORPHA:1727)
- Ventricular septal defect (HP:0001629): A hole between the two bottom chambers (ventricles) of the heart. The defect is centered around the most superior aspect of the ventricular septum. Evidence: TAS. Frequency: Occasional (HP:0040283). (ORPHA:1727)
- Tetralogy of Fallot (HP:0001636): A congenital cardiac malformation comprising pulmonary stenosis, overriding aorta, ventricular septum defect, and right ventricular hypertrophy. The diagnosis of TOF is made if at least three of the four above mentioned features are present. Evidence: TAS. Frequency: Occasional (HP:0040283). (ORPHA:1727)
- Transposition of the great arteries (HP:0001669): A complex congenital heart defect in which the aorta arises from the morphologic right ventricle and the pulmonary artery arises from the morphologic left ventricle. Evidence: TAS. Frequency: Occasional (HP:0040283). (ORPHA:1727)
- Abnormal speech pattern (HP:0002167): An abnormality in the sound (volume) or cadence (rate) of speech. Evidence: TAS. Frequency: Frequent (HP:0040282). (ORPHA:1727)
- Scoliosis (HP:0002650): The presence of an abnormal lateral curvature of the spine. Evidence: TAS. Frequency: Occasional (HP:0040283). (ORPHA:1727)
- Hypoplastic left ventricle (HP:0004383): A severe congenital heart defect characterized by underdevelopment of the left ventricle. Evidence: TAS. Frequency: Occasional (HP:0040283). (ORPHA:1727)
- Attention deficit hyperactivity disorder (HP:0007018): Attention deficit hyperactivity disorder (ADHD) manifests at age 2-3 years or by first grade at the latest. The main symptoms are distractibility, impulsivity, hyperactivity, and often trouble organizing tasks and projects, difficulty going to sleep, and social problems from being aggressive, loud, or impatient. Evidence: TAS. Frequency: Occasional (HP:0040283). (ORPHA:1727)
- Urethral stenosis (HP:0008661): Abnormal narrowing of the urethra. Evidence: TAS. Frequency: Occasional (HP:0040283). (ORPHA:1727)
- Anterior creases of earlobe (HP:0009908): Sharply demarcated, typically linear and approximately horizontal, indentations in the outer surface of the ear lobe. Evidence: TAS. Frequency: Occasional (HP:0040283). (ORPHA:1727)
- Aplasia/Hypoplasia of the thymus (HP:0010515): Absence or underdevelopment of the thymus. Evidence: TAS. Frequency: Occasional (HP:0040283). (ORPHA:1727)
- Abnormality of immune system physiology (HP:0010978): A functional abnormality of the immune system. Evidence: TAS. Frequency: Occasional (HP:0040283). (ORPHA:1727)
- Interrupted aortic arch (HP:0011611): Non-continuity of the arch of aorta with an atretic point or absent segment. Evidence: TAS. Frequency: Occasional (HP:0040283). (ORPHA:1727)
- Midface retrusion (HP:0011800): Posterior positions and/or vertical shortening of the infraorbital and perialar regions, or increased concavity of the face and/or reduced nasolabial angle. Evidence: TAS. Frequency: Frequent (HP:0040282). (ORPHA:1727)
- Displacement of the urethral meatus (HP:0100627): A displacement of the external urethral orifice from its normal position (in males normally placed at the tip of glans penis, in females normally placed about 2.5 cm behind the glans clitoridis and immediately in front of that of the vagina). Evidence: TAS. Frequency: Occasional (HP:0040283). (ORPHA:1727)
These phenotypes are associated with the disease 22q11.2 duplication syndrome (ORPHA:1727).